- Miscarriage (HP:0005268, a Human Phenotype Ontology term): A pregnancy that ends at a stage in which the fetus is incapable of surviving on its own, defined as the spontaneous loss of a fetus before the 22th week of pregnancy. Evidence: IEA. (OMIM:300087)
This phenotype is associated with the disease X inactivation, familial skewed, 1 (OMIM:300087, an entry in Online Mendelian Inheritance in Man).